- Inguinal hernia (HP:0000023, a Human Phenotype Ontology term): Protrusion of the contents of the abdominal cavity through the inguinal canal. Evidence: IEA. (OMIM:142350)
- Autosomal dominant inheritance (HP:0000006, a Human Phenotype Ontology term): A mode of inheritance that is observed for traits related to a gene encoded on one of the autosomes (i.e., the human chromosomes 1-22) in which a trait manifests in heterozygotes. In the context of medical genetics, an autosomal dominant disorder is caused when a single copy of the mutant allele is present. Males and females are affected equally, and can both transmit the disorder with a risk of 50% for each child of inheriting the mutant allele. Evidence: TAS. (OMIM:142350)
These phenotypes are associated with the disease hernia, double inguinal (OMIM:142350, an entry in Online Mendelian Inheritance in Man).